- Reduced alpha/beta synthesis ratio (HP:0011907): A reduction in the ratio of production of alpha globin to that of beta globin. This is the major abnormality in the various forms of alpha thalassemia. Evidence: TAS. (OMIM:604131)
- Hypochromic microcytic anemia (HP:0004840): A type of anemia characterized by an abnormally low concentration of hemoglobin in the erythrocytes and lower than normal size of the erythrocytes. Evidence: TAS. (OMIM:604131)
These phenotypes are associated with the disease alpha thalassemia spectrum (OMIM:604131).